- Sensorineural hearing impairment (HP:0000407): A type of hearing impairment in one or both ears related to an abnormal functionality of the cochlear nerve. Evidence: TAS. Frequency: Very frequent (HP:0040281). (ORPHA:3239)
- Hypopigmented skin patches (HP:0001053). Evidence: TAS. Frequency: Very frequent (HP:0040281). (ORPHA:3239)
- EEG abnormality (HP:0002353): Abnormality observed by electroencephalogram (EEG), which is used to record of the brain's spontaneous electrical activity from multiple electrodes placed on the scalp. Evidence: TAS. Frequency: Very frequent (HP:0040281). (ORPHA:3239)
- Achalasia (HP:0002571): A disorder of esophageal motility characterized by the inability of the lower esophageal sphincter to relax during swallowing and by inadequate or lacking peristalsis in the lower half of the body of the esophagus. Evidence: TAS. Frequency: Very frequent (HP:0040281). (ORPHA:3239)
- Skeletal muscle atrophy (HP:0003202): The presence of skeletal muscular atrophy (which is also known as amyotrophy). Evidence: TAS. Frequency: Very frequent (HP:0040281). (ORPHA:3239)
- Severe short stature (HP:0003510): A severe degree of short stature, more than -4 SD from the mean corrected for age and sex. Evidence: TAS. Frequency: Very frequent (HP:0040281). (ORPHA:3239)
These phenotypes are associated with the disease Deafness-vitiligo-achalasia syndrome (ORPHA:3239).